- Abnormal vestibular function (HP:0001751): An abnormality of the functioning of the vestibular apparatus. Evidence: PCS. Frequency: 0/8. (PMID:36355422)
- Sensorineural hearing impairment (HP:0000407): A type of hearing impairment in one or both ears related to an abnormal functionality of the cochlear nerve. Evidence: PCS. Frequency: 8/8. (PMID:36355422)
- Autosomal recessive inheritance (HP:0000007): A mode of inheritance that is observed for traits related to a gene encoded on one of the autosomes (i.e., the human chromosomes 1-22) in which a trait manifests in individuals with two pathogenic alleles, either homozygotes (two copies of the same mutant allele) or compound heterozygotes (whereby each copy of a gene has a distinct mutant allele). Evidence: PCS. (PMID:36355422)
- Macrocephaly (HP:0000256): Occipitofrontal (head) circumference greater than 97th centile compared to appropriate, age matched, sex-matched normal standards. Alternatively, a apparently increased size of the cranium. Evidence: PCS. Frequency: 1/8. (PMID:36355422)
- Intellectual disability (HP:0001249): The term intellectual disability or intellectual developmental disorder is used to describe significantly sub-average intellectual and adaptive functioning based on clinical assessment and as measured by individually administered, appropriately normed, standardized and validated tests of intellectual functioning and adaptive behavior, with onset during the developmental period from infancy through adolescence. Evidence: PCS. Frequency: 0/8. (PMID:36355422)
These phenotypes are associated with the disease hearing loss, autosomal recessive 123 (OMIM:620745).